Phenotypes associated with the disease myoclonus, familial, 2 (OMIM:618364):
- Dystonia (HP:0001332): An abnormally increased muscular tone that causes fixed abnormal postures. There is a slow, intermittent twisting motion that leads to exaggerated turning and posture of the extremities and trunk. Evidence: PCS. Frequency: 0/2. (PMID:29726066)
- Delayed ability to walk (HP:0031936): A failure to achieve the ability to walk at an appropriate developmental stage. Most children learn to walk in a series of stages, and learn to walk short distances independently between 12 and 15 months. Evidence: PCS. Frequency: 1/2. (PMID:29726066)
- Seizure (HP:0001250): A seizure is an intermittent abnormality of nervous system physiology characterized by a transient occurrence of signs and/or symptoms due to abnormal excessive or synchronous neuronal activity in the brain. Evidence: IEA. Frequency: 0/2. (PMID:29726066)
- Nonprogressive (HP:0003680): Applies to a disease manifestation that does not increase in scope or severity over the course of time, i.e., that does not worsen with age. Evidence: PCS. (PMID:29726066)
- Autosomal dominant inheritance (HP:0000006): A mode of inheritance that is observed for traits related to a gene encoded on one of the autosomes (i.e., the human chromosomes 1-22) in which a trait manifests in heterozygotes. In the context of medical genetics, an autosomal dominant disorder is caused when a single copy of the mutant allele is present. Males and females are affected equally, and can both transmit the disorder with a risk of 50% for each child of inheriting the mutant allele. Evidence: PCS. (PMID:29726066)
- Intellectual disability (HP:0001249): The term intellectual disability or intellectual developmental disorder is used to describe significantly sub-average intellectual and adaptive functioning based on clinical assessment and as measured by individually administered, appropriately normed, standardized and validated tests of intellectual functioning and adaptive behavior, with onset during the developmental period from infancy through adolescence. Evidence: PCS. Frequency: 0/2. (PMID:29726066)
- Limb myoclonus (HP:0045084). Evidence: PCS. Frequency: 5/5. Onset: Juvenile onset (HP:0003621). (PMID:29726066)